- Juvenile onset (HP:0003621): Onset of signs or symptoms of disease between the age of 5 and 15 years. Evidence: PCS. (PMID:27523597)
- Myocardial fibrosis (HP:0001685): Myocardial fibrosis is characterized by dysregulated collagen turnover (increased synthesis predominates over unchanged or decreased degradation) and excessive diffuse collagen accumulation in the interstitial and perivascular spaces as well as by phenotypically transformed fibroblasts, termed myofibroblasts. Evidence: PCS. (PMID:27523597)
- Autosomal recessive inheritance (HP:0000007): A mode of inheritance that is observed for traits related to a gene encoded on one of the autosomes (i.e., the human chromosomes 1-22) in which a trait manifests in individuals with two pathogenic alleles, either homozygotes (two copies of the same mutant allele) or compound heterozygotes (whereby each copy of a gene has a distinct mutant allele). Evidence: PCS. (PMID:27523597)
- Chest pain (HP:0100749): An unpleasant sensation characterized by physical discomfort (such as pricking, throbbing, or aching) localized to the chest. Evidence: PCS. (PMID:27523597)
These phenotypes are associated with the disease sudden cardiac failure, alcohol-induced (OMIM:617223).